- Axial hypotonia (HP:0008936): Muscular hypotonia (abnormally low muscle tone) affecting the musculature of the trunk. Evidence: PCS. Frequency: 1/9. (PMID:22002931)
- Mild intellectual disability (HP:0001256): Mild intellectual disability (ID) is defined as a type of ID characterized by mildly sub-average adaptive functioning and intellectual functioning, with an intelligence quotient (IQ) the range of 50-69. Evidence: PCS. Frequency: 2/5. (PMID:9106537)
- Generalized non-motor (absence) seizure (HP:0002121): A generalized non-motor (absence) seizure is a type of a type of dialeptic seizure that is of electrographically generalized onset. It is a generalized seizure characterized by an interruption of activities, a blank stare, and usually the person will be unresponsive when spoken to. Any ictal motor phenomena are minor in comparison to these non-motor features. Evidence: PCS. Frequency: 1/9. (PMID:22002931)
- Global developmental delay (HP:0001263): A delay in the achievement of motor or mental milestones in the domains of development of a child, including motor skills, speech and language, cognitive skills, and social and emotional skills. This term should only be used to describe children younger than five years of age. Evidence: PCS. (PMID:22002931)
- Specific learning disability (HP:0001328): Impairment of certain skills such as reading or writing, coordination, self-control, or attention that interfere with the ability to learn. The impairment is not related to a global deficiency of intelligence. Evidence: PCS. Frequency: 2/4. (PMID:22002931)
- X-linked inheritance (HP:0001417): A mode of inheritance that is observed for traits related to a gene encoded on the X chromosome. Evidence: PCS. (PMID:22002931)
- X-linked dominant inheritance (HP:0001423): A mode of inheritance that is observed for dominant traits related to a gene encoded on the X chromosome. In the context of medical genetics, X-linked dominant disorders tend to manifest very severely in affected males. The severity of manifestation in females may depend on the degree of skewed X inactivation. Evidence: PCS. (PMID:9106537)
- Intellectual disability (HP:0001249): The term intellectual disability or intellectual developmental disorder is used to describe significantly sub-average intellectual and adaptive functioning based on clinical assessment and as measured by individually administered, appropriately normed, standardized and validated tests of intellectual functioning and adaptive behavior, with onset during the developmental period from infancy through adolescence. Evidence: PCS. (PMID:22002931)
- Intellectual disability (HP:0001249): The term intellectual disability or intellectual developmental disorder is used to describe significantly sub-average intellectual and adaptive functioning based on clinical assessment and as measured by individually administered, appropriately normed, standardized and validated tests of intellectual functioning and adaptive behavior, with onset during the developmental period from infancy through adolescence. Evidence: PCS. Frequency: 9/9. (PMID:22002931)
- Severe intellectual disability (HP:0010864): Severe intellectual disability (ID) is defined as a type of ID characterized by severely sub-average adaptive functioning and intellectual functioning, with an intelligence quotient (IQ) the range of 20-34. Evidence: PCS. Frequency: 7/7. (PMID:9106537)
These phenotypes are associated with the disease intellectual disability, X-linked 41 (OMIM:300849).